Phenotypes associated with the disease developmental and epileptic encephalopathy, 49 (OMIM:617281):
- Bilateral tonic-clonic seizure (HP:0002069): A bilateral tonic-clonic seizure is a seizure defined by a tonic (bilateral increased tone, lasting seconds to minutes) and then a clonic (bilateral sustained rhythmic jerking) phase. Evidence: PCS. Frequency: 3/3. (PMID:27866705)
- Exaggerated startle response (HP:0002267): An exaggerated startle reaction in response to a sudden unexpected visual or acoustic stimulus, or a quick movement near the face. Evidence: PCS. Frequency: 1/3. (PMID:27866705)
- Dysplastic corpus callosum (HP:0006989): Dysplasia and dysgenesis of the corpus callosum are nonspecific descriptions that imply defective development of the corpus callosum. The term dysplasia is applied when the morphology of the corpus callosum is altered as a congenital trait. For instance, the corpus callosum may be hump-shaped, kinked, or a striped corpus callosum that lacks an anatomically distinct genu and splenium. Evidence: PCS. Frequency: 2/3. (PMID:27866705)
- Tented upper lip vermilion (HP:0010804): Triangular appearance of the oral aperture with the apex in the midpoint of the upper vermilion and the lower vermilion forming the base. Evidence: PCS. Frequency: 3/3. (PMID:27866705)
- Myoclonic seizure (HP:0032794): A myoclonic seizure is a type of motor seizure characterized by sudden, brief (<100 ms) involuntary single or multiple contraction of muscles or muscle groups of variable topography (axial, proximal limb, distal). Myoclonus is less regularly repetitive and less sustained than is clonus. Evidence: PCS. Frequency: 2/3. (PMID:27866705)
- Coarse facial features (HP:0000280): Absence of fine and sharp appearance of brows, nose, lips, mouth, and chin, usually because of rounded and heavy features or thickened skin with or without thickening of subcutaneous and bony tissues. Evidence: PCS. Frequency: 3/3. (PMID:27866705)
- Anxiety (HP:0000739): Intense feelings of nervousness, tension, or panic often arise in response to interpersonal stresses. There is worry about the negative effects of past unpleasant experiences and future negative possibilities. Individuals may feel fearful, apprehensive, or threatened by uncertainty, and they may also have fears of falling apart or losing control. Evidence: PCS. Frequency: 1/3. (PMID:27866705)
- Arachnoid cyst (HP:0100702): An extra-parenchymal and intra-arachnoidal collection of fluid with a composition similar to that of cerebrospinal fluid. Evidence: PCS. Frequency: 1/3. (PMID:27866705)
- Facial-lingual fasciculations (HP:0007089): Fasciculations affecting the tongue muscle and the musculature of the face. Evidence: PCS. Frequency: 1/3. (PMID:27866705)
- Clonic seizure (HP:0020221): A clonic seizure is a type of motor seizure characterized by sustained rhythmic jerking, that is regularly repetitive. Evidence: PCS. Frequency: 2/3. (PMID:27866705)
- Dandy-Walker malformation (HP:0001305): A congenital brain malformation typically characterized by incomplete formation of the cerebellar vermis, dilation of the fourth ventricle, and enlargement of the posterior fossa. In layman's terms, Dandy Walker malformation is a cyst in the cerebellum (typically symmetrical) that is involved with the fourth ventricle. This may interfere with the ability to drain cerebrospinal fluid from the brain, resulting in hydrocephalus. Dandy Walker cysts are formed during early embryonic development, while the brain forms. The cyst in the cerebellum typically has several blood vessels running through it connecting to the brain, thereby prohibiting surgical removal. Evidence: PCS. Frequency: 1/3. (PMID:27866705)
- Hydrocephalus (HP:0000238): Hydrocephalus is an active distension of the ventricular system of the brain resulting from inadequate passage of CSF from its point of production within the cerebral ventricles to its point of absorption into the systemic circulation. Evidence: PCS. Frequency: 1/3. (PMID:27866705)
- Ventriculomegaly (HP:0002119): An increase in size of the ventricular system of the brain. Evidence: PCS. Frequency: 2/3. (PMID:27866705)
- Hyperactivity (HP:0000752): Hyperactivity is a condition characterized by constant and unusually high levels of activity, even in situations where it is deemed inappropriate. Evidence: PCS. Frequency: 1/3. (PMID:27866705)
- Cerebral calcification (HP:0002514): The presence of calcium deposition within the cerebrum. Evidence: PCS. Frequency: 1/3. (PMID:27866705)
- Thick upper lip vermilion (HP:0000215): Height of the vermilion of the upper lip in the midline more than 2 SD above the mean. Alternatively, an apparently increased height of the vermilion of the upper lip in the frontal view (subjective). Evidence: IEA. (OMIM:617281)
- Hyperreflexia (HP:0001347): Hyperreflexia is the presence of hyperactive stretch reflexes of the muscles. Evidence: IEA. (OMIM:617281)
- Neonatal onset (HP:0003623): Onset of signs or symptoms of disease within the first 28 days of life. Evidence: PCS. Frequency: 3/3. (PMID:27866705)
- Axial hypotonia (HP:0008936): Muscular hypotonia (abnormally low muscle tone) affecting the musculature of the trunk. Evidence: IEA. (OMIM:617281)
- Basal ganglia calcification (HP:0002135): The presence of calcium deposition affecting one or more structures of the basal ganglia. Evidence: PCS. Frequency: 2/3. (PMID:27866705)
- Cerebellar vermis hypoplasia (HP:0001320): Underdevelopment of the vermis of cerebellum. Evidence: PCS. Frequency: 1/3. (PMID:27866705)
- Microcephaly (HP:0000252): Head circumference below 2 standard deviations below the mean for age and gender. Evidence: PCS. Frequency: 3/3. (PMID:27866705)
- Spastic tetraplegia (HP:0002510): Spastic paralysis affecting all four limbs. Evidence: PCS. Frequency: 2/3. (PMID:27866705)
- Absent speech (HP:0001344): Complete lack of development of speech and language abilities. Evidence: PCS. Frequency: 1/3. (PMID:27866705)
- EEG abnormality (HP:0002353): Abnormality observed by electroencephalogram (EEG), which is used to record of the brain's spontaneous electrical activity from multiple electrodes placed on the scalp. Evidence: PCS. Frequency: 3/3. (PMID:27866705)
- Thick eyebrow (HP:0000574): Increased density/number and/or increased diameter of eyebrow hairs. Evidence: PCS. Frequency: 3/3. (PMID:27866705)
- Everted lower lip vermilion (HP:0000232): An abnormal configuration of the lower lip such that it is turned outward i.e., everted, with the Inner aspect of the lower lip vermilion (normally opposing the teeth) being visible in a frontal view. Evidence: PCS. Frequency: 3/3. (PMID:27866705)
- Open mouth (HP:0000194): A facial appearance characterized by a permanently or nearly permanently opened mouth. Evidence: PCS. Frequency: 3/3. (PMID:27866705)
- Global developmental delay (HP:0001263): A delay in the achievement of motor or mental milestones in the domains of development of a child, including motor skills, speech and language, cognitive skills, and social and emotional skills. This term should only be used to describe children younger than five years of age. Evidence: PCS. Frequency: 2/3. (PMID:27866705)
- Profound global developmental delay (HP:0012736): A profound delay in the achievement of motor or mental milestones in the domains of development of a child. Evidence: TAS. (OMIM:617281)
- Severe global developmental delay (HP:0011344): A severe delay in the achievement of motor or mental milestones in the domains of development of a child. Evidence: PCS. Frequency: 3/3. (PMID:27866705)
- Tonic seizure (HP:0032792): A tonic seizure is a type of motor seizure characterized by unilateral or bilateral limb stiffening or elevation, often with neck stiffening. Evidence: PCS. Frequency: 2/3. (PMID:27866705)
- Prominent nose (HP:0000448): Distance between subnasale and pronasale more than two standard deviations above the mean, or alternatively, an apparently increased anterior protrusion of the nasal tip. Evidence: PCS. Frequency: 3/3. (PMID:27866705)
- Autosomal recessive inheritance (HP:0000007): A mode of inheritance that is observed for traits related to a gene encoded on one of the autosomes (i.e., the human chromosomes 1-22) in which a trait manifests in individuals with two pathogenic alleles, either homozygotes (two copies of the same mutant allele) or compound heterozygotes (whereby each copy of a gene has a distinct mutant allele). Evidence: PCS. (PMID:27866705)
- Epileptic encephalopathy (HP:0200134): A condition in which epileptiform abnormalities are believed to contribute to the progressive disturbance in cerebral function. Epileptic encephalaopathy is characterized by (1) electrographic EEG paroxysmal activity that is often aggressive, (2) seizures that are usually multiform and intractable, (3) cognitive, behavioral and neurological deficits that may be relentless, and (4) sometimes early death. Evidence: PCS. Frequency: 3/3. (PMID:27866705)
- Long eyelashes (HP:0000527): Mid upper eyelash length >10 mm or increased length of the eyelashes (subjective). Evidence: PCS. Frequency: 3/3. (PMID:27866705)
- Optic atrophy (HP:0000648): Atrophy of the optic nerve. Optic atrophy results from the death of the retinal ganglion cell axons that comprise the optic nerve and manifesting as a pale optic nerve on fundoscopy. Evidence: IEA. Frequency: Very rare (HP:0040284). (OMIM:617281)
- Frontal bossing (HP:0002007): Bilateral bulging of the lateral frontal bone prominences with relative sparing of the midline. Evidence: IEA. (OMIM:617281)
- Macrotia (HP:0000400): Median longitudinal ear length greater than two standard deviations above the mean and median ear width greater than two standard deviations above the mean (objective); or, apparent increase in length and width of the pinna (subjective). Evidence: PCS. Frequency: 3/3. (PMID:27866705)
- Short philtrum (HP:0000322): Distance between nasal base and midline upper lip vermilion border more than 2 SD below the mean. Alternatively, an apparently decreased distance between nasal base and midline upper lip vermilion border. Evidence: PCS. Frequency: 3/3. (PMID:27866705)
- Spasticity (HP:0001257): A motor disorder characterized by a velocity-dependent increase in tonic stretch reflexes with increased muscle tone, exaggerated (hyperexcitable) tendon reflexes. Evidence: IEA. (OMIM:617281)
- Myoclonus (HP:0001336): Very brief, involuntary random muscular contractions occurring at rest, in response to sensory stimuli, or accompanying voluntary movements. Evidence: PCS. Frequency: 1/3. (PMID:27866705)